Phenotypes associated with the disease Idiopathic trachyonychia (ORPHA:79153):
- Nail dystrophy (HP:0008404): Onychodystrophy (nail dystrophy) refers to nail changes apart from changes of the color (nail dyschromia) and involves partial or complete disruption of the various keratinous layers of the nail plate. Evidence: TAS. Frequency: Very frequent (HP:0040281). (ORPHA:79153)
- Concave nail (HP:0001598): The natural longitudinal (posterodistal) convex arch is not present or is inverted. Evidence: TAS. Frequency: Frequent (HP:0040282). (ORPHA:79153)
- Nail pits (HP:0001803): Small (typically about 1 mm or less in size) depressions on the dorsal nail surface. Evidence: TAS. Frequency: Frequent (HP:0040282). (ORPHA:79153)
- Ridged nail (HP:0001807): Longitudinal, linear prominences in the nail plate. Evidence: TAS. Frequency: Frequent (HP:0040282). (ORPHA:79153)
- Fragile nails (HP:0001808): Nails that easily break. Evidence: TAS. Frequency: Frequent (HP:0040282). (ORPHA:79153)
- Thin nail (HP:0001816): Nail that appears thin when viewed on end. Evidence: TAS. Frequency: Frequent (HP:0040282). (ORPHA:79153)
- Fingernail dysplasia (HP:0100798): An abnormality of the development of the fingernails. Evidence: TAS. Frequency: Frequent (HP:0040282). (ORPHA:79153)
- Abnormal periungual morphology (HP:0100803): An abnormality of the region around the nails of the fingers or toes. Evidence: TAS. Frequency: Frequent (HP:0040282). (ORPHA:79153)
- Patchy alopecia (HP:0002232): Transient, non-scarring hair loss and preservation of the hair follicle located in in well-defined patches. Evidence: TAS. Frequency: Occasional (HP:0040283). (ORPHA:79153)
- Circumungual hyperkeratosis (HP:0008399): A thickening of the stratum corneum, the outer layer of the skin, in the region surrounding the nails. Evidence: TAS. Frequency: Occasional (HP:0040283). (ORPHA:79153)
- Toenail dysplasia (HP:0100797): An abnormality of the development of the toenails. Evidence: TAS. Frequency: Occasional (HP:0040283). (ORPHA:79153)
- Vitiligo (HP:0001045). Evidence: TAS. Frequency: Very rare (HP:0040284). (ORPHA:79153)
- Atopic dermatitis (HP:0001047): Atopic dermatitis (AD) or atopic eczema is an itchy, inflammatory skin condition with a predilection for the skin flexures. It is characterized by poorly defined erythema with edema, vesicles, and weeping in the acute stage and skin thickening (lichenification) in the chronic stage. Evidence: TAS. Frequency: Very rare (HP:0040284). (ORPHA:79153)
- Autoimmune thrombocytopenia (HP:0001973): The presence of thrombocytopenia in combination with detection of antiplatelet antibodies. Evidence: TAS. Frequency: Very rare (HP:0040284). (ORPHA:79153)
- Ichthyosis (HP:0008064): An abnormality of the skin characterized the presence of excessive amounts of dry surface scales on the skin resulting from an abnormality of keratinization. Evidence: TAS. Frequency: Very rare (HP:0040284). (ORPHA:79153)
- Amyloid deposition (HP:0011034): Pathologic deposits of specific fibrillar protein aggregates with distinct microscopic properties, particularly affinity for the dye Congo red with typical birefringence. Evidence: TAS. Frequency: Very rare (HP:0040284). (ORPHA:79153)
Not associated with this disease:
- Pain (HP:0012531): An unpleasant sensory and emotional experience associated with actual or potential tissue damage, or described in terms of such damage. Evidence: TAS. (ORPHA:79153)